Phenotypes associated with the disease left ventricular noncompaction 2 (OMIM:609470):
- Left ventricular noncompaction cardiomyopathy (HP:0011664): Left ventricular non-compaction (LVNC) is characterized by prominent left ventricular trabeculae and deep inter-trabecular recesses. The myocardial wall is often thickened with a thin, compacted epicardial layer and a thickened endocardial layer. In some patients, LVNC is associated with left ventricular dilatation and systolic dysfunction, which can be transient in neonates. Evidence: PCS. (PMID:15173023)
- Autosomal dominant inheritance (HP:0000006): A mode of inheritance that is observed for traits related to a gene encoded on one of the autosomes (i.e., the human chromosomes 1-22) in which a trait manifests in heterozygotes. In the context of medical genetics, an autosomal dominant disorder is caused when a single copy of the mutant allele is present. Males and females are affected equally, and can both transmit the disorder with a risk of 50% for each child of inheriting the mutant allele. Evidence: PCS. (PMID:15173023)